- Prominent occiput (HP:0000269): Increased convexity of the occiput (posterior part of the skull). Evidence: TAS. Frequency: Very frequent (HP:0040281). (ORPHA:2612)
- Facial asymmetry (HP:0000324): An abnormal difference between the left and right sides of the face. Evidence: TAS. Frequency: Frequent (HP:0040282). (ORPHA:2612)
- Abnormality of the eye (HP:0000478): Any abnormality of the eye, including location, spacing, and intraocular abnormalities. Evidence: TAS. Frequency: Frequent (HP:0040282). (ORPHA:2612)
- Abnormality of vision (HP:0000504): Abnormality of eyesight (visual perception). Evidence: TAS. Frequency: Frequent (HP:0040282). (ORPHA:2612)
- Telecanthus (HP:0000506): Distance between the inner canthi more than two standard deviations above the mean (objective); or, apparently increased distance between the inner canthi. Evidence: TAS. Frequency: Very frequent (HP:0040281). (ORPHA:2612)
- Microphthalmia (HP:0000568): A developmental anomaly characterized by abnormal smallness of one or both eyes. Evidence: TAS. Frequency: Very frequent (HP:0040281). (ORPHA:2612)
- Iris coloboma (HP:0000612): A coloboma of the iris. Evidence: TAS. Frequency: Very frequent (HP:0040281). (ORPHA:2612)
- Melanocytic nevus (HP:0000995): A oval and round, colored (usually medium-to dark brown, reddish brown, or flesh colored) lesion. Typically, a melanocytic nevus is less than 6 mm in diameter, but may be much smaller or larger. Evidence: TAS. Frequency: Very frequent (HP:0040281). (ORPHA:2612)
- Cavernous hemangioma (HP:0001048): The presence of a cavernous hemangioma. A hemangioma characterized by large endothelial spaces (caverns) is called a cavernous hemangioma. Evidence: TAS. Frequency: Very frequent (HP:0040281). (ORPHA:2612)
- Intellectual disability (HP:0001249): The term intellectual disability or intellectual developmental disorder is used to describe significantly sub-average intellectual and adaptive functioning based on clinical assessment and as measured by individually administered, appropriately normed, standardized and validated tests of intellectual functioning and adaptive behavior, with onset during the developmental period from infancy through adolescence. Evidence: TAS. Frequency: Very frequent (HP:0040281). (ORPHA:2612)
- Seizure (HP:0001250): A seizure is an intermittent abnormality of nervous system physiology characterized by a transient occurrence of signs and/or symptoms due to abnormal excessive or synchronous neuronal activity in the brain. Evidence: TAS. Frequency: Very frequent (HP:0040281). (ORPHA:2612)
- Hypotonia (HP:0001252): Hypotonia is an abnormally low muscle tone (the amount of tension or resistance to movement in a muscle). Even when relaxed, muscles have a continuous and passive partial contraction which provides some resistance to passive stretching. Hypotonia thus manifests as diminished resistance to passive stretching. Hypotonia is not the same as muscle weakness, although the two conditions can co-exist. Evidence: TAS. Frequency: Very frequent (HP:0040281). (ORPHA:2612)
- Dandy-Walker malformation (HP:0001305): A congenital brain malformation typically characterized by incomplete formation of the cerebellar vermis, dilation of the fourth ventricle, and enlargement of the posterior fossa. In layman's terms, Dandy Walker malformation is a cyst in the cerebellum (typically symmetrical) that is involved with the fourth ventricle. This may interfere with the ability to drain cerebrospinal fluid from the brain, resulting in hydrocephalus. Dandy Walker cysts are formed during early embryonic development, while the brain forms. The cyst in the cerebellum typically has several blood vessels running through it connecting to the brain, thereby prohibiting surgical removal. Evidence: TAS. Frequency: Occasional (HP:0040283). (ORPHA:2612)
- Diminished deep tendon reflex (HP:0001315): A reduction (hyporeflexia) or complete absence (areflexia) of the involuntary muscle contraction normally elicited by a reflex stimulus, such as tapping a deep tendon. Evidence: TAS. Frequency: Very frequent (HP:0040281). (ORPHA:2612)
- Hyperreflexia (HP:0001347): Hyperreflexia is the presence of hyperactive stretch reflexes of the muscles. Evidence: TAS. Frequency: Very frequent (HP:0040281). (ORPHA:2612)
- Plagiocephaly (HP:0001357): Asymmetric head shape, which is usually a combination of unilateral occipital flattening with ipsilateral frontal prominence, leading to rhomboid cranial shape. Evidence: TAS. Frequency: Frequent (HP:0040282). (ORPHA:2612)
- Growth delay (HP:0001510): A deficiency or slowing down of growth pre- and postnatally. Evidence: TAS. Frequency: Occasional (HP:0040283). (ORPHA:2612)
- Alopecia (HP:0001596): A noncongenital process of hair loss, which may progress to partial or complete baldness. Evidence: TAS. Frequency: Very frequent (HP:0040281). (ORPHA:2612)
- Frontal bossing (HP:0002007): Bilateral bulging of the lateral frontal bone prominences with relative sparing of the midline. Evidence: TAS. Frequency: Very frequent (HP:0040281). (ORPHA:2612)
- Ventriculomegaly (HP:0002119): An increase in size of the ventricular system of the brain. Evidence: TAS. Frequency: Very frequent (HP:0040281). (ORPHA:2612)
- Porencephalic cyst (HP:0002132): A cavity within the cerebral hemisphere, filled with cerebrospinal fluid, that communicates directly with the ventricular system. Evidence: TAS. Frequency: Frequent (HP:0040282). (ORPHA:2612)
- EEG abnormality (HP:0002353): Abnormality observed by electroencephalogram (EEG), which is used to record of the brain's spontaneous electrical activity from multiple electrodes placed on the scalp. Evidence: TAS. Frequency: Very frequent (HP:0040281). (ORPHA:2612)
- Cerebral calcification (HP:0002514): The presence of calcium deposition within the cerebrum. Evidence: TAS. Frequency: Occasional (HP:0040283). (ORPHA:2612)
- Genu recurvatum (HP:0002816): An abnormally increased extension of the knee joint, so that the knee can bend backwards. Evidence: TAS. Frequency: Very frequent (HP:0040281). (ORPHA:2612)
- Vertebral segmentation defect (HP:0003422): An abnormality related to a defect of vertebral separation during development. Evidence: TAS. Frequency: Very frequent (HP:0040281). (ORPHA:2612)
- Biparietal narrowing (HP:0004422): A narrowing of the biparietal diameter (i.e., of the transverse distance between the protuberances of the two parietal bones of the skull). Evidence: TAS. Frequency: Very frequent (HP:0040281). (ORPHA:2612)
- Aplasia/Hypoplasia of the cerebellum (HP:0007360). Evidence: TAS. Frequency: Very frequent (HP:0040281). (ORPHA:2612)
- Aplasia/Hypoplasia of the corpus callosum (HP:0007370): Absence or underdevelopment of the corpus callosum. Evidence: TAS. Frequency: Occasional (HP:0040283). (ORPHA:2612)
- Irregular hyperpigmentation (HP:0007400). Evidence: TAS. Frequency: Frequent (HP:0040282). (ORPHA:2612)
- Adenoma sebaceum (HP:0009720): The presence of a sebaceous adenoma with origin in the sebum secreting cells of the skin. Evidence: TAS. Frequency: Very frequent (HP:0040281). (ORPHA:2612)
- Asymmetric growth (HP:0100555): A growth pattern that displays an abnormal difference between the left and the right side. Evidence: TAS. Frequency: Very frequent (HP:0040281). (ORPHA:2612)
These phenotypes are associated with the disease Linear nevus sebaceus syndrome (ORPHA:2612).